Phenotypes associated with the disease Burning mouth syndrome (ORPHA:353253):
- Dysesthesia (HP:0012534): Painful sensations elicited by a nonpainful cutaneous stimulus such as a light touch or gentle stroking over affected areas of the body. Sometimes referred to as hyperpathia or hyperalgesia. Often perceived as an intense burning, dyesthesias may outlast the stimulus by several seconds. Evidence: TAS. Frequency: Occasional (HP:0040283). (ORPHA:353253)
- Parageusia (HP:0031249): A distortion of the sense of taste, often characterized by the sensation of a metallic taste. Evidence: TAS. Frequency: Frequent (HP:0040282). (ORPHA:353253)
- Impaired temperature sensation (HP:0010829): A reduced ability to discriminate between different temperatures. Evidence: TAS. Frequency: Occasional (HP:0040283). (ORPHA:353253)
- Abnormal fifth cranial nerve morphology (HP:0010824): Any structural abnormality of the fifth cranial nerve. Evidence: TAS. Frequency: Occasional (HP:0040283). (ORPHA:353253)
- Abnormality of somatosensory evoked potentials (HP:0007377): An abnormality of somatosensory evoked potentials (SSEP), i.e., of the electrical signals of sensation going from the body to the brain in response to a defined stimulus. Recording electrodes are placed over the scalp, spine, and peripheral nerves proximal to the stimulation site. Clinical studies generally use electrical stimulation of peripheral nerves to elicit potentials. SSEP testing determines whether peripheral sensory nerves are able to transmit sensory information like pain, temperature, and touch to the brain. Abnormal SSEPs can result from dysfunction at the level of the peripheral nerve, plexus, spinal root, spinal cord, brain stem, thalamocortical projections, or primary somatosensory cortex. Evidence: TAS. Frequency: Occasional (HP:0040283). (ORPHA:353253)
- Burning mouth (HP:0032143): An intense sensation of burning, scalding, or tingling feeling of the tongue or other regions of the oral mucosa. Evidence: TAS. Frequency: Very frequent (HP:0040281). (ORPHA:353253)
- Abnormality of taste sensation (HP:0000223). Evidence: TAS. Frequency: Frequent (HP:0040282). (ORPHA:353253)
- Anxiety (HP:0000739): Intense feelings of nervousness, tension, or panic often arise in response to interpersonal stresses. There is worry about the negative effects of past unpleasant experiences and future negative possibilities. Individuals may feel fearful, apprehensive, or threatened by uncertainty, and they may also have fears of falling apart or losing control. Evidence: TAS. Frequency: Frequent (HP:0040282). (ORPHA:353253)
- Depression (HP:0000716): Frequently experiencing feelings of being down, miserable, and/or hopeless; struggling to recover from these moods; having a pessimistic outlook on the future; feeling a pervasive sense of shame; having a low self-worth; experiencing thoughts of suicide and engaging in suicidal behavior. Evidence: TAS. Frequency: Frequent (HP:0040282). (ORPHA:353253)
- Tongue pain (HP:0030811): An unpleasant sensation characterized by physical discomfort (such as pricking, throbbing, or aching) localized to the tongue. Evidence: TAS. Frequency: Occasional (HP:0040283). (ORPHA:353253)
- Abnormality of the gingiva (HP:0000168): Any abnormality of the gingiva (also known as gums). Evidence: TAS. Frequency: Occasional (HP:0040283). (ORPHA:353253)
- Xerostomia (HP:0000217): Dryness of the mouth due to salivary gland dysfunction. Evidence: TAS. Frequency: Occasional (HP:0040283). (ORPHA:353253)
- Headache (HP:0002315): Cephalgia, or pain sensed in various parts of the head, not confined to the area of distribution of any nerve. Evidence: TAS. Frequency: Occasional (HP:0040283). (ORPHA:353253)
- Sleep disturbance (HP:0002360): An abnormal pattern in the quality, quantity, or characteristics of sleep. Evidence: TAS. Frequency: Occasional (HP:0040283). (ORPHA:353253)
- Emotional lability (HP:0000712): Unstable emotional experiences and frequent mood changes; emotions that are easily aroused, intense, and/or disproportionate to events and circumstances. Evidence: TAS. Frequency: Occasional (HP:0040283). (ORPHA:353253)
- Strawberry tongue (HP:0031042): Inflamed tongue with hyperplastic (enlarged) fungiform papillae that is said to resemble a strawberry or raspberry. Evidence: TAS. Frequency: Occasional (HP:0040283). (ORPHA:353253)
- Smooth tongue (HP:0010298): Glossy appearance of the entire tongue surface. Evidence: TAS. Frequency: Occasional (HP:0040283). (ORPHA:353253)